Phenotypes associated with the disease intellectual disability, autosomal recessive 14 (OMIM:614020):
- Narrow palate (HP:0000189): Width of the palate more than 2 SD below the mean (objective) or apparently decreased palatal width (subjective). Evidence: PCS. Frequency: 3/4. (PMID:21212097)
- Delayed speech and language development (HP:0000750): A degree of language development that is significantly below the norm for a child of a specified age. Evidence: PCS. Frequency: 4/4. (PMID:21212097)
- Infantile onset (HP:0003593): Onset of signs or symptoms of disease between 28 days to one year of life. Evidence: PCS. Frequency: 4/4. (PMID:21212097)
- Autosomal recessive inheritance (HP:0000007): A mode of inheritance that is observed for traits related to a gene encoded on one of the autosomes (i.e., the human chromosomes 1-22) in which a trait manifests in individuals with two pathogenic alleles, either homozygotes (two copies of the same mutant allele) or compound heterozygotes (whereby each copy of a gene has a distinct mutant allele). Evidence: PCS. (PMID:21212097)
- Intention tremor (HP:0002080): A type of kinetic tremor that occurs during target directed movement is called intention tremor. That is, an oscillatory cerebellar ataxia that tends to be absent when the limbs are inactive and during the first part of voluntary movement but worsening as the movement continues and greater precision is required (e.g., in touching a target such as the patient's nose or a physician's finger). Evidence: PCS. Frequency: 3/4. (PMID:21212097)
- Intellectual disability (HP:0001249): The term intellectual disability or intellectual developmental disorder is used to describe significantly sub-average intellectual and adaptive functioning based on clinical assessment and as measured by individually administered, appropriately normed, standardized and validated tests of intellectual functioning and adaptive behavior, with onset during the developmental period from infancy through adolescence. Evidence: PCS. Frequency: 4/4. (PMID:21212097)